Phenotypes associated with the disease microtia-eye coloboma-imperforation of the nasolacrimal duct syndrome (OMIM:611863):
- Microtia (HP:0008551): Underdevelopment of the external ear. Evidence: IEA. (OMIM:611863)
- Autosomal dominant inheritance (HP:0000006): A mode of inheritance that is observed for traits related to a gene encoded on one of the autosomes (i.e., the human chromosomes 1-22) in which a trait manifests in heterozygotes. In the context of medical genetics, an autosomal dominant disorder is caused when a single copy of the mutant allele is present. Males and females are affected equally, and can both transmit the disorder with a risk of 50% for each child of inheriting the mutant allele. Evidence: TAS. (OMIM:611863)